Phenotypes associated with the disease congenital stationary night blindness autosomal dominant 3 (OMIM:610444):
- Early-onset non-progressive night blindness (HP:0007642): A usually nonprogressive (i.e., stationary) form of night blindness with early (presumed to be congenital) onset. Evidence: PCS. (PMID:8673138)
- Autosomal dominant inheritance (HP:0000006): A mode of inheritance that is observed for traits related to a gene encoded on one of the autosomes (i.e., the human chromosomes 1-22) in which a trait manifests in heterozygotes. In the context of medical genetics, an autosomal dominant disorder is caused when a single copy of the mutant allele is present. Males and females are affected equally, and can both transmit the disorder with a risk of 50% for each child of inheriting the mutant allele. Evidence: PCS. (PMID:8673138)